Phenotypes associated with the disease Peters plus syndrome (ORPHA:709):
- Hypospadias (HP:0000047): Abnormal position of urethral meatus on the ventral penile shaft (underside) characterized by displacement of the urethral meatus from the tip of the glans penis to the ventral surface of the penis, scrotum, or perineum. Evidence: TAS. Frequency: Frequent (HP:0040282). (ORPHA:709)
- Cleft palate (HP:0000175): Cleft palate is a developmental defect of the palate resulting from a failure of fusion of the palatine processes and manifesting as a separation of the roof of the mouth (soft and hard palate). Evidence: TAS. Frequency: Frequent (HP:0040282). (ORPHA:709)
- Cleft upper lip (HP:0000204): A gap or groove in the upper lip. This is a congenital defect resulting from nonfusion of tissues of the lip during embryonal development. Evidence: TAS. Frequency: Frequent (HP:0040282). (ORPHA:709)
- Hydrocephalus (HP:0000238): Hydrocephalus is an active distension of the ventricular system of the brain resulting from inadequate passage of CSF from its point of production within the cerebral ventricles to its point of absorption into the systemic circulation. Evidence: TAS. Frequency: Frequent (HP:0040282). (ORPHA:709)
- Hypertelorism (HP:0000316): Interpupillary distance more than 2 SD above the mean (alternatively, the appearance of an increased interpupillary distance or widely spaced eyes). Evidence: TAS. Frequency: Frequent (HP:0040282). (ORPHA:709)
- Preauricular skin tag (HP:0000384): A rudimentary tag of skin often containing ear tissue including a core of cartilage and located just anterior to the auricle (outer part of the ear). Evidence: TAS. Frequency: Frequent (HP:0040282). (ORPHA:709)
- Webbed neck (HP:0000465): Pterygium colli is a congenital skin fold that runs along the sides of the neck down to the shoulders. It involves an ectopic fibrotic facial band superficial to the trapezius muscle. Excess hair-bearing skin is also present and extends down the cervical region well beyond the normal hairline. Evidence: TAS. Frequency: Frequent (HP:0040282). (ORPHA:709)
- Microcornea (HP:0000482): A congenital abnormality of the cornea in which the cornea and the anterior segment of the eye are smaller than normal. The horizontal diameter of the cornea does not reach 10 mm even in adulthood. Evidence: TAS. Frequency: Frequent (HP:0040282). (ORPHA:709)
- Abnormality of vision (HP:0000504): Abnormality of eyesight (visual perception). Evidence: TAS. Frequency: Frequent (HP:0040282). (ORPHA:709)
- Cataract (HP:0000518): A cataract is an opacity or clouding that develops in the crystalline lens of the eye or in its capsule. Evidence: TAS. Frequency: Frequent (HP:0040282). (ORPHA:709)
- Upslanted palpebral fissure (HP:0000582): The palpebral fissure inclination is more than two standard deviations above the mean for age (objective); or, the inclination of the palpebral fissure is greater than typical for age. Evidence: TAS. Frequency: Frequent (HP:0040282). (ORPHA:709)
- Nystagmus (HP:0000639): Rhythmic, involuntary oscillations of one or both eyes related to abnormality in fixation, conjugate gaze, or vestibular mechanisms. Evidence: TAS. Frequency: Frequent (HP:0040282). (ORPHA:709)
- Widely spaced teeth (HP:0000687): Increased spaces (diastemata) between most of the teeth in the same dental arch. Evidence: TAS. Frequency: Frequent (HP:0040282). (ORPHA:709)
- Decreased fetal movement (HP:0001558): An abnormal reduction in quantity or strength of fetal movements. Evidence: TAS. Frequency: Frequent (HP:0040282). (ORPHA:709)
- Pulmonic stenosis (HP:0001642): A narrowing of the right ventricular outflow tract that can occur at the pulmonary valve (valvular stenosis), below the pulmonary valve (infundibular stenosis), or above the pulmonary valve (supravalvar stenosis). Evidence: TAS. Frequency: Frequent (HP:0040282). (ORPHA:709)
- Abnormal cardiac septum morphology (HP:0001671): An anomaly of the intra-atrial or intraventricular septum. Evidence: TAS. Frequency: Frequent (HP:0040282). (ORPHA:709)
- Toe syndactyly (HP:0001770): Webbing or fusion of the toes, involving soft parts only or including bone structure. Bony fusions are referred to as "bony" Syndactyly if the fusion occurs in a radio-ulnar axis. Fusions of bones of the toes in a proximo-distal axis are referred to as "Symphalangism". Evidence: TAS. Frequency: Frequent (HP:0040282). (ORPHA:709)
- Frontal bossing (HP:0002007): Bilateral bulging of the lateral frontal bone prominences with relative sparing of the midline. Evidence: TAS. Frequency: Frequent (HP:0040282). (ORPHA:709)
- Short stature (HP:0004322): A height below that which is expected according to age and gender norms. Although there is no universally accepted definition of short stature, many refer to "short stature" as height more than 2 standard deviations below the mean for age and gender (or below the 3rd percentile for age and gender dependent norms). Evidence: TAS. Frequency: Frequent (HP:0040282). (ORPHA:709)
- Abnormality of the pulmonary artery (HP:0004414): An abnormality of the pulmonary artery. Evidence: TAS. Frequency: Frequent (HP:0040282). (ORPHA:709)
- Preauricular pit (HP:0004467): Small indentation anterior to the insertion of the ear. Evidence: TAS. Frequency: Frequent (HP:0040282). (ORPHA:709)
- Microtia, second degree (HP:0008569): Median longitudinal length of the ear more than two standard deviations below the mean in the presence of some, but not all, parts of the normal ear. Evidence: TAS. Frequency: Frequent (HP:0040282). (ORPHA:709)
- Feeding difficulties in infancy (HP:0008872): Impaired feeding performance of an infant as manifested by difficulties such as weak and ineffective sucking, brief bursts of sucking, and falling asleep during sucking. There may be difficulties with chewing or maintaining attention. Evidence: TAS. Frequency: Frequent (HP:0040282). (ORPHA:709)
- Postnatal growth retardation (HP:0008897): Slow or limited growth after birth. Evidence: TAS. Frequency: Frequent (HP:0040282). (ORPHA:709)
- Prominent forehead (HP:0011220): Forward prominence of the entire forehead, due to protrusion of the frontal bone. Evidence: TAS. Frequency: Frequent (HP:0040282). (ORPHA:709)
- Short palpebral fissure (HP:0012745): Distance between the medial and lateral canthi is more than 2 SD below the mean for age (objective); or, apparently reduced length of the palpebral fissures. Evidence: TAS. Frequency: Frequent (HP:0040282). (ORPHA:709)
- Multicystic kidney dysplasia (HP:0000003): Multicystic dysplasia of the kidney is characterized by multiple cysts of varying size in the kidney and the absence of a normal pelvicaliceal system. The condition is associated with ureteral or ureteropelvic atresia, and the affected kidney is nonfunctional. Evidence: TAS. Frequency: Occasional (HP:0040283). (ORPHA:709)
- Hypoplasia of the uterus (HP:0000013): Underdevelopment of the uterus. Evidence: TAS. Frequency: Occasional (HP:0040283). (ORPHA:709)
- Inguinal hernia (HP:0000023): Protrusion of the contents of the abdominal cavity through the inguinal canal. Evidence: TAS. Frequency: Occasional (HP:0040283). (ORPHA:709)
- Clitoral hypoplasia (HP:0000060): Developmental hypoplasia of the clitoris. Evidence: TAS. Frequency: Occasional (HP:0040283). (ORPHA:709)
- Ureteral duplication (HP:0000073): A developmental anomaly characterized by the presence of two, instead of one, ureter connecting a kidney to the bladder. Evidence: TAS. Frequency: Occasional (HP:0040283). (ORPHA:709)
- Renal duplication (HP:0000075): A congenital anomaly of the urinary tract, in which the kidney is duplicated and is drained via two separate renal pelves and ureters. Evidence: TAS. Frequency: Occasional (HP:0040283). (ORPHA:709)
- Hydronephrosis (HP:0000126): Severe distention of the kidney with dilation of the renal pelvis and calices. Evidence: TAS. Frequency: Occasional (HP:0040283). (ORPHA:709)
- Wide mouth (HP:0000154): Distance between the oral commissures more than 2 SD above the mean. Alternatively, an apparently increased width of the oral aperture (subjective). Evidence: TAS. Frequency: Occasional (HP:0040283). (ORPHA:709)
- Microcephaly (HP:0000252): Head circumference below 2 standard deviations below the mean for age and gender. Evidence: TAS. Frequency: Occasional (HP:0040283). (ORPHA:709)
- Conductive hearing impairment (HP:0000405): An abnormality of vibrational conductance of sound to the inner ear leading to impairment of sensory perception of sound. Evidence: TAS. Frequency: Occasional (HP:0040283). (ORPHA:709)
- Anteverted nares (HP:0000463): Anteriorly-facing nostrils viewed with the head in the Frankfurt horizontal and the eyes of the observer level with the eyes of the subject. This gives the appearance of an upturned nose (upturned nasal tip). Evidence: TAS. Frequency: Occasional (HP:0040283). (ORPHA:709)
- Visual impairment (HP:0000505): Visual impairment (or vision impairment) is vision loss (of a person) to such a degree as to qualify as an additional support need through a significant limitation of visual capability resulting from either disease, trauma, or congenital or degenerative conditions that cannot be corrected by conventional means, such as refractive correction, medication, or surgery. Evidence: TAS. Frequency: Occasional (HP:0040283). (ORPHA:709)
- Optic atrophy (HP:0000648): Atrophy of the optic nerve. Optic atrophy results from the death of the retinal ganglion cell axons that comprise the optic nerve and manifesting as a pale optic nerve on fundoscopy. Evidence: TAS. Frequency: Occasional (HP:0040283). (ORPHA:709)
- Anterior hypopituitarism (HP:0000830): A condition of reduced function of the anterior pituitary gland characterized by decreased secretion of one or more of the pituitary hormones growth hormone, thyroid-stimulating hormone, adrenocorticotropic hormone, prolactin, luteinizing hormone, and follicle-stimulating hormone. Evidence: TAS. Frequency: Occasional (HP:0040283). (ORPHA:709)
- Congenital hypothyroidism (HP:0000851): A type of hypothyroidism with congenital onset. Evidence: TAS. Frequency: Occasional (HP:0040283). (ORPHA:709)
- Sacral dimple (HP:0000960): A cutaneous indentation resulting from tethering of the skin to underlying structures (bone) of the intergluteal cleft. Evidence: TAS. Frequency: Occasional (HP:0040283). (ORPHA:709)
- Umbilical hernia (HP:0001537): Protrusion of abdominal contents through a defect in the abdominal wall musculature around the umbilicus. Skin and subcutaneous tissue overlie the defect. Evidence: TAS. Frequency: Occasional (HP:0040283). (ORPHA:709)
- Polyhydramnios (HP:0001561): The presence of excess amniotic fluid in the uterus during pregnancy. Evidence: TAS. Frequency: Occasional (HP:0040283). (ORPHA:709)
- Patent ductus arteriosus (HP:0001643): In utero, the ductus arteriosus (DA) serves to divert ventricular output away from the lungs and toward the placenta by connecting the main pulmonary artery to the descending aorta. A patent ductus arteriosus (PDA) in the first 3 days of life is a physiologic shunt in healthy term and preterm newborn infants, and normally is substantially closed within about 24 hours after bith and completely closed after about three weeks. Failure of physiologcal closure is referred to a persistent or patent ductus arteriosus (PDA). Depending on the degree of left-to-right shunting, PDA can have clinical consequences. Evidence: TAS. Frequency: Occasional (HP:0040283). (ORPHA:709)
- Anal atresia (HP:0002023): Congenital absence of the anus, i.e., the opening at the bottom end of the intestinal tract. Evidence: TAS. Frequency: Occasional (HP:0040283). (ORPHA:709)
- Ventriculomegaly (HP:0002119): An increase in size of the ventricular system of the brain. Evidence: TAS. Frequency: Occasional (HP:0040283). (ORPHA:709)
- Cerebral cortical atrophy (HP:0002120): Atrophy of the cortex of the cerebrum. Evidence: TAS. Frequency: Occasional (HP:0040283). (ORPHA:709)
- Short nose (HP:0003196): Distance from nasion to subnasale more than two standard deviations below the mean, or alternatively, an apparently decreased length from the nasal root to the nasal tip. Evidence: TAS. Frequency: Occasional (HP:0040283). (ORPHA:709)
- Spina bifida occulta (HP:0003298): The closed form of spina bifida with incomplete closure of a vertebral body with intact overlying skin. Evidence: TAS. Frequency: Occasional (HP:0040283). (ORPHA:709)
- Depressed nasal bridge (HP:0005280): Posterior positioning of the nasal root in relation to the overall facial profile for age. Evidence: TAS. Frequency: Occasional (HP:0040283). (ORPHA:709)
- Wide intermamillary distance (HP:0006610): A larger than usual distance between the left and right nipple. Evidence: TAS. Frequency: Occasional (HP:0040283). (ORPHA:709)
- Aplasia/Hypoplasia of the corpus callosum (HP:0007370): Absence or underdevelopment of the corpus callosum. Evidence: TAS. Frequency: Occasional (HP:0040283). (ORPHA:709)
- Renal hypoplasia/aplasia (HP:0008678): Absence or underdevelopment of the kidney. Evidence: TAS. Frequency: Occasional (HP:0040283). (ORPHA:709)
- Rhizomelia (HP:0008905): Disproportionate shortening of the proximal segment of limbs (i.e. the femur and humerus). Evidence: TAS. Frequency: Occasional (HP:0040283). (ORPHA:709)
- Intestinal fistula (HP:0100819): An abnormal connection between the gut and another hollow organ, such as the bladder, urethra, vagina, or other regions of the gastrointestinal tract. Evidence: TAS. Frequency: Occasional (HP:0040283). (ORPHA:709)
- Hypoplastic left ventricle (HP:0004383): A severe congenital heart defect characterized by underdevelopment of the left ventricle. Evidence: TAS. Frequency: Very rare (HP:0040284). (ORPHA:709)
- Bicuspid pulmonary valve (HP:0005182): The presence of a bicuspid pulmonary valve. Evidence: TAS. Frequency: Very rare (HP:0040284). (ORPHA:709)
- Abnormal pulmonary vein morphology (HP:0030968): An abnormality of the structure of the pulmonary veins. Evidence: TAS. Frequency: Very rare (HP:0040284). (ORPHA:709)
- Thin upper lip vermilion (HP:0000219): Height of the vermilion of the upper lip in the midline more than 2 SD below the mean. Alternatively, an apparently reduced height of the vermilion of the upper lip in the frontal view (subjective). Evidence: TAS. Frequency: Very frequent (HP:0040281). (ORPHA:709)
- Brachycephaly (HP:0000248): An abnormality of skull shape characterized by a decreased anterior-posterior diameter. That is, a cephalic index greater than 81%. Alternatively, an apparently shortened anteroposterior dimension (length) of the head compared to width. Evidence: TAS. Frequency: Very frequent (HP:0040281). (ORPHA:709)
- Long face (HP:0000276): Facial height (length) is more than 2 standard deviations above the mean (objective); or, an apparent increase in the height (length) of the face (subjective). Evidence: TAS. Frequency: Very frequent (HP:0040281). (ORPHA:709)
- Round face (HP:0000311): The facial appearance is more circular than usual as viewed from the front. Evidence: TAS. Frequency: Very frequent (HP:0040281). (ORPHA:709)
- Long philtrum (HP:0000343): Distance between nasal base and midline upper lip vermilion border more than 2 SD above the mean. Alternatively, an apparently increased distance between nasal base and midline upper lip vermilion border. Evidence: TAS. Frequency: Very frequent (HP:0040281). (ORPHA:709)
- Micrognathia (HP:0000347): Developmental hypoplasia of the mandible. Evidence: TAS. Frequency: Very frequent (HP:0040281). (ORPHA:709)
- Short neck (HP:0000470): Diminished length of the neck. Evidence: TAS. Frequency: Very frequent (HP:0040281). (ORPHA:709)
- Glaucoma (HP:0000501): Glaucoma refers loss of retinal ganglion cells in a characteristic pattern of optic neuropathy usually associated with increased intraocular pressure. Evidence: TAS. Frequency: Very frequent (HP:0040281). (ORPHA:709)
- Peters anomaly (HP:0000659): A form of anterior segment dysgenesis in which abnormal cleavage of the anterior chamber occurs. Peters anomaly is characterized by central, paracentral, or complete corneal opacity. Evidence: TAS. Frequency: Very frequent (HP:0040281). (ORPHA:709)
- Brachydactyly (HP:0001156): Digits that appear disproportionately short compared to the hand/foot. The word brachydactyly is used here to describe a series distinct patterns of shortened digits (brachydactyly types A-E). This is the sense used here. Evidence: TAS. Frequency: Very frequent (HP:0040281). (ORPHA:709)
- Intellectual disability (HP:0001249): The term intellectual disability or intellectual developmental disorder is used to describe significantly sub-average intellectual and adaptive functioning based on clinical assessment and as measured by individually administered, appropriately normed, standardized and validated tests of intellectual functioning and adaptive behavior, with onset during the developmental period from infancy through adolescence. Evidence: TAS. Frequency: Very frequent (HP:0040281). (ORPHA:709)
- Global developmental delay (HP:0001263): A delay in the achievement of motor or mental milestones in the domains of development of a child, including motor skills, speech and language, cognitive skills, and social and emotional skills. This term should only be used to describe children younger than five years of age. Evidence: TAS. Frequency: Very frequent (HP:0040281). (ORPHA:709)
- Intrauterine growth retardation (HP:0001511): An abnormal restriction of fetal growth with fetal weight below the tenth percentile for gestational age. Evidence: TAS. Frequency: Very frequent (HP:0040281). (ORPHA:709)
- Short foot (HP:0001773): A measured foot length that is more than 2 SD below the mean for a newborn of 27 - 41 weeks gestation, or foot that is less than the 3rd centile for individuals from birth to 16 years of age (objective). Alternatively, a foot that appears disproportionately short (subjective). Evidence: TAS. Frequency: Very frequent (HP:0040281). (ORPHA:709)
- Short toe (HP:0001831): A toe that appears disproportionately short compared to the foot. Evidence: TAS. Frequency: Very frequent (HP:0040281). (ORPHA:709)
- Short columella (HP:0002000): Reduced distance from the anterior border of the naris to the subnasale. Evidence: TAS. Frequency: Very frequent (HP:0040281). (ORPHA:709)
- Exaggerated cupid's bow (HP:0002263): More pronounced paramedian peaks and median notch of the Cupid's bow. Evidence: TAS. Frequency: Very frequent (HP:0040281). (ORPHA:709)
- Micromelia (HP:0002983): The presence of abnormally small extremities. Evidence: TAS. Frequency: Very frequent (HP:0040281). (ORPHA:709)
- Clinodactyly of the 5th finger (HP:0004209): Clinodactyly refers to a bending or curvature of the fifth finger in the radial direction (i.e., towards the 4th finger). Evidence: TAS. Frequency: Very frequent (HP:0040281). (ORPHA:709)
- Anterior chamber synechiae (HP:0007833). Evidence: TAS. Frequency: Very frequent (HP:0040281). (ORPHA:709)
- Corneal opacity (HP:0007957): A reduction of corneal clarity. Evidence: TAS. Frequency: Very frequent (HP:0040281). (ORPHA:709)
- Disproportionate short-limb short stature (HP:0008873): A type of disproportionate short stature characterized by a short limbs but an average-sized trunk. Evidence: TAS. Frequency: Very frequent (HP:0040281). (ORPHA:709)
- Cryptorchidism (HP:0000028): Testis in inguinal canal. That is, absence of one or both testes from the scrotum owing to failure of the testis or testes to descend through the inguinal canal to the scrotum. Evidence: TAS. Frequency: Frequent (HP:0040282). (ORPHA:709)
- Posteriorly rotated ears (HP:0000358): A type of abnormal location of the ears in which the position of the ears is characterized by posterior rotation (the superior part of the ears is rotated towards the back of the head, and the inferior part of the ears towards the front). Evidence: TAS. Frequency: Occasional (HP:0040283). (ORPHA:709)